Phenotypes associated with the disease nephrotic syndrome, type 4 (OMIM:256370):
- Stage 5 chronic kidney disease (HP:0003774): A degree of kidney failure severe enough to require dialysis or kidney transplantation for survival characterized by a severe reduction in glomerular filtration rate (less than 15 ml/min/1.73 m2) and other manifestations including increased serum creatinine. Evidence: PCS. Frequency: 18/19. (PMID:9529364)
- Progressive (HP:0003676): Applies to a disease manifestation that increases in scope or severity over the course of time, i.e., that worsens with age. Evidence: PCS. (PMID:9529364)
- Ectopic testis (HP:6000460): Localization of the testis in an anatomic location other than the scrotum. Evidence: PCS. Frequency: 1/14. (PMID:9529364)
- Nephrotic syndrome (HP:0000100): Nephrotic syndrome is a collection of findings resulting from glomerular dysfunction with an increase in glomerular capillary wall permeability associated with pronounced proteinuria. Nephrotic syndrome refers to the constellation of clinical findings that result from severe renal loss of protein, with Proteinuria and hypoalbuminemia, edema, and hyperlipidemia. Evidence: PCS. Frequency: 24/24. (PMID:9529364)
- Ambiguous genitalia (HP:0000062): A genital phenotype that is not clearly assignable to a single gender. Ambiguous genitalia can be evaluated using the Prader scale: Prader 0: Normal female external genitalia. Prader 1: Female external genitalia with clitoromegaly. Prader 2: Clitoromegaly with partial labial fusion forming a funnel-shaped urogenital sinus. Prader 3: Increased phallic enlargement. Complete labioscrotal fusion forming a urogenital sinus with a single opening. Prader 4: Complete scrotal fusion with urogenital opening at the base or on the shaft of the phallus. Prader 5: Normal male external genitalia. The diagnosis of ambiguous genitalia is made for Prader 1-4. Evidence: PCS. Frequency: 7/24. (PMID:9529364)
- Gonadoblastoma (HP:0000150): The presence of a gonadoblastoma, a neoplasm of a gonad that consists of aggregates of germ cells and sex cord elements. Evidence: PCS. Frequency: 2/24. (PMID:9529364)
- Childhood onset (HP:0011463): Onset of disease at the age of between 1 and 5 years. Evidence: PCS. (PMID:9529364)
- Renal insufficiency (HP:0000083): A reduction in the level of performance of the kidneys in areas of function comprising the concentration of urine, removal of wastes, the maintenance of electrolyte balance, homeostasis of blood pressure, and calcium metabolism. Evidence: PCS. (PMID:9529364)
- Focal segmental glomerulosclerosis (HP:0000097): Segmental accumulation of scar tissue in individual (but not all) glomeruli. Evidence: TAS. Frequency: Occasional (HP:0040283). (OMIM:256370)
- Diffuse mesangial sclerosis (HP:0001967): Thickening and scarring (sclerosis) of the mesangium (a structure in the glomerulus). The sclerosis affects a large portion of the mesangium across multiple glomeruli. Histologic features include an increase in the mesangial matrix, thickened glomerular basement membrane, tubular casts, and interstitial inflammation. Diffuse mesangial sclerosis presents with nephrotic syndrome at birth or within the first year of life. Glomeruli are small and condensed in appearance, with early lesions showing increased loose mesangial collagen that progress to sclerosis with dense collagen without hypercellularity. Podocytes do not show hyperplasia but may be immature and cobblestone-like. Electron microscopy shows extensive foot process effacement without deposits, but increased collagen within mesangial areas. Evidence: PCS. Frequency: 20/20. (PMID:9529364)
- Nephroblastoma (HP:0002667): The presence of a nephroblastoma, which is a neoplasm of the kidney that primarily affects children. Evidence: IEA. (OMIM:256370)
- Autosomal dominant inheritance (HP:0000006): A mode of inheritance that is observed for traits related to a gene encoded on one of the autosomes (i.e., the human chromosomes 1-22) in which a trait manifests in heterozygotes. In the context of medical genetics, an autosomal dominant disorder is caused when a single copy of the mutant allele is present. Males and females are affected equally, and can both transmit the disorder with a risk of 50% for each child of inheriting the mutant allele. Evidence: PCS. (PMID:9529364)